Phenotypes associated with the disease intellectual disability, autosomal dominant 5 (OMIM:612621):
- Bilateral tonic-clonic seizure (HP:0002069): A bilateral tonic-clonic seizure is a seizure defined by a tonic (bilateral increased tone, lasting seconds to minutes) and then a clonic (bilateral sustained rhythmic jerking) phase. Evidence: PCS. Frequency: 1/3. (PMID:19196676)
- Torticollis (HP:0000473): Involuntary contractions of the neck musculature resulting in an abnormal posture of or abnormal movements of the head. Evidence: PCS. Frequency: 1/3. (PMID:19196676)
- Microcephaly (HP:0000252): Head circumference below 2 standard deviations below the mean for age and gender. Evidence: PCS. Frequency: 1/3. (PMID:21237447)
- EEG abnormality (HP:0002353): Abnormality observed by electroencephalogram (EEG), which is used to record of the brain's spontaneous electrical activity from multiple electrodes placed on the scalp. Evidence: TAS. (OMIM:612621)
- Moderate intellectual disability (HP:0002342): Moderate intellectual disability (ID) is defined as a type of ID characterized by moderately sub-average adaptive functioning and intellectual functioning, with an intelligence quotient (IQ) the range of 35-49. Evidence: PCS. Frequency: 6/6. (PMID:19196676;PMID:21237447)
- Language impairment (HP:0002463): Language impairment is a deficit in comprehension or production of language that includes reduced vocabulary, limited sentence structure, or impairments in written or spoken communication. Language abilities are substantially and quantifiably below age expectations. Evidence: PCS. (PMID:21237447)
- Strabismus (HP:0000486): A misalignment of the eyes so that the visual axes deviate from bifoveal fixation. The classification of strabismus may be based on a number of features including the relative position of the eyes, whether the deviation is latent or manifest, intermittent or constant, concomitant or otherwise and according to the age of onset and the relevance of any associated refractive error. Evidence: PCS. Frequency: 1/3. (PMID:19196676)
- Developmental regression (HP:0002376): Loss of developmental skills, as manifested by loss of developmental milestones. Evidence: TAS. (OMIM:612621)
- Seizure (HP:0001250): A seizure is an intermittent abnormality of nervous system physiology characterized by a transient occurrence of signs and/or symptoms due to abnormal excessive or synchronous neuronal activity in the brain. Evidence: PCS. Frequency: 4/6. (PMID:21237447)
- Global developmental delay (HP:0001263): A delay in the achievement of motor or mental milestones in the domains of development of a child, including motor skills, speech and language, cognitive skills, and social and emotional skills. This term should only be used to describe children younger than five years of age. Evidence: PCS. Frequency: 3/3. (PMID:19196676)
- Hypotonia (HP:0001252): Hypotonia is an abnormally low muscle tone (the amount of tension or resistance to movement in a muscle). Even when relaxed, muscles have a continuous and passive partial contraction which provides some resistance to passive stretching. Hypotonia thus manifests as diminished resistance to passive stretching. Hypotonia is not the same as muscle weakness, although the two conditions can co-exist. Evidence: PCS. Frequency: 3/3. (PMID:19196676)
- Infantile onset (HP:0003593): Onset of signs or symptoms of disease between 28 days to one year of life. Evidence: PCS. Frequency: 3/3. (PMID:19196676)
- Motor delay (HP:0001270): A type of Developmental delay characterized by a delay in acquiring motor skills. Evidence: PCS. Frequency: 3/3. (PMID:19196676)
- Brain atrophy (HP:0012444): Partial or complete wasting (loss) of brain tissue that was once present. Evidence: PCS. Frequency: 1/3. (PMID:21237447)
- Myoclonic absence seizure (HP:0011150): Myoclonic absence seizure is a type of generalized non-motor (absence) seizure characterized by an interruption of ongoing activities, a blank stare and rhythmic three-per-second myoclonic movements, causing ratcheting abduction of the upper limbs leading to progressive arm elevation, and associated with 3 Hz generalized spike-wave discharges on the electroencephalogram. Duration is typically 10-60 s. Whilst impairment of consciousness may not be obvious the ILAE classified this seizure as a generalized non-motor seizure in 2017. Evidence: PCS. Frequency: 1/3. (PMID:19196676)
- Autistic behavior (HP:0000729): Persistent deficits in social interaction and communication and interaction as well as a markedly restricted repertoire of activity and interest as well as repetitive patterns of behavior. Evidence: PCS. Frequency: 1/3. (PMID:21237447)
- Epileptic encephalopathy (HP:0200134): A condition in which epileptiform abnormalities are believed to contribute to the progressive disturbance in cerebral function. Epileptic encephalaopathy is characterized by (1) electrographic EEG paroxysmal activity that is often aggressive, (2) seizures that are usually multiform and intractable, (3) cognitive, behavioral and neurological deficits that may be relentless, and (4) sometimes early death. Evidence: PCS. (PMID:19196676)
- Drooling (HP:0002307): Habitual flow of saliva out of the mouth. Evidence: PCS. Frequency: 1/3. (PMID:19196676)
- Autosomal dominant inheritance (HP:0000006): A mode of inheritance that is observed for traits related to a gene encoded on one of the autosomes (i.e., the human chromosomes 1-22) in which a trait manifests in heterozygotes. In the context of medical genetics, an autosomal dominant disorder is caused when a single copy of the mutant allele is present. Males and females are affected equally, and can both transmit the disorder with a risk of 50% for each child of inheriting the mutant allele. Evidence: PCS. (PMID:19196676)
- Congenital muscular torticollis (HP:0005988): A congenital form of torticollis resulting from shortening of the sternocleidomastoid muscle and leading to a limited range of motion in both rotation and lateral bending. Evidence: PCS. Frequency: 1/3. (PMID:19196676)
- Intellectual disability (HP:0001249): The term intellectual disability or intellectual developmental disorder is used to describe significantly sub-average intellectual and adaptive functioning based on clinical assessment and as measured by individually administered, appropriately normed, standardized and validated tests of intellectual functioning and adaptive behavior, with onset during the developmental period from infancy through adolescence. Evidence: TAS. (OMIM:612621)